- Triphalangeal thumb (HP:0001199): A thumb with three phalanges in a single, proximo-distal axis. Thus, this term applies if the thumb has an accessory phalanx, leading to a digit like appearance of the thumb. Evidence: IEA. (OMIM:190650)
- Short stature (HP:0004322): A height below that which is expected according to age and gender norms. Although there is no universally accepted definition of short stature, many refer to "short stature" as height more than 2 standard deviations below the mean for age and gender (or below the 3rd percentile for age and gender dependent norms). Evidence: IEA. (OMIM:190650)
- Recurrent patellar dislocation (HP:0005001): Patellar dislocation occurring repeated times. Evidence: TAS. (OMIM:190650)
- Autosomal dominant inheritance (HP:0000006): A mode of inheritance that is observed for traits related to a gene encoded on one of the autosomes (i.e., the human chromosomes 1-22) in which a trait manifests in heterozygotes. In the context of medical genetics, an autosomal dominant disorder is caused when a single copy of the mutant allele is present. Males and females are affected equally, and can both transmit the disorder with a risk of 50% for each child of inheriting the mutant allele. Evidence: IEA. (OMIM:190650)
These phenotypes are associated with the disease Say-field-Coldwell syndrome (OMIM:190650).